Phenotypes associated with the disease LUTHERAN NULL (OMIM:247420):
- Autosomal recessive inheritance (HP:0000007): A mode of inheritance that is observed for traits related to a gene encoded on one of the autosomes (i.e., the human chromosomes 1-22) in which a trait manifests in individuals with two pathogenic alleles, either homozygotes (two copies of the same mutant allele) or compound heterozygotes (whereby each copy of a gene has a distinct mutant allele). Evidence: IEA. (OMIM:247420)
- Absence of Lutheran antigen on erythrocytes (HP:0010971): Absence of the Lutheran antigen (a type I integral membrane glycoprotein) from the surface of red blood cells. Evidence: IEA. (OMIM:247420)